- Progressive encephalopathy (HP:0002448). Evidence: TAS. Frequency: Obligate (HP:0040280). (ORPHA:363400)
- Hyperinsulinemia (HP:0000842): An increased concentration of insulin in the blood. Evidence: TAS. Frequency: Very frequent (HP:0040281). (ORPHA:363400)
- Insulin resistance (HP:0000855): Increased resistance towards insulin, that is, diminished effectiveness of insulin in reducing blood glucose levels. Evidence: TAS. Frequency: Very frequent (HP:0040281). (ORPHA:363400)
- Reduced subcutaneous adipose tissue (HP:0003758): A reduced amount of fat tissue in the lowest layer of the integument. This feature can be appreciated by a reduced skinfold thickness. Evidence: TAS. Frequency: Very frequent (HP:0040281). (ORPHA:363400)
- Progressive psychomotor deterioration (HP:0007272). Evidence: TAS. Frequency: Very frequent (HP:0040281). (ORPHA:363400)
- Generalized lipodystrophy (HP:0009064): Generalized degenerative changes of the fat tissue. Evidence: TAS. Frequency: Very frequent (HP:0040281). (ORPHA:363400)
- Reduced intraabdominal adipose tissue (HP:0025128): An abnormally reduced amount of adipose tissue in the abdominal cavity. Evidence: TAS. Frequency: Very frequent (HP:0040281). (ORPHA:363400)
- Cognitive impairment (HP:0100543): Abnormal cognition is characterized by deficits in thinking, reasoning, or remembering. Evidence: TAS. Frequency: Very frequent (HP:0040281). (ORPHA:363400)
- Coarse facial features (HP:0000280): Absence of fine and sharp appearance of brows, nose, lips, mouth, and chin, usually because of rounded and heavy features or thickened skin with or without thickening of subcutaneous and bony tissues. Evidence: TAS. Frequency: Frequent (HP:0040282). (ORPHA:363400)
- Delayed speech and language development (HP:0000750): A degree of language development that is significantly below the norm for a child of a specified age. Evidence: TAS. Frequency: Frequent (HP:0040282). (ORPHA:363400)
- Seizure (HP:0001250): A seizure is an intermittent abnormality of nervous system physiology characterized by a transient occurrence of signs and/or symptoms due to abnormal excessive or synchronous neuronal activity in the brain. Evidence: TAS. Frequency: Frequent (HP:0040282). (ORPHA:363400)
- Ataxia (HP:0001251): Ataxia refers to impaired coordination of voluntary muscle movement. Cerebellar ataxia refers to ataxia due to dysfunction of the cerebellum. This causes a variety of elementary neurological deficits including asynergy (lack of coordination between muscles, limbs and joints), dysmetria (lack of ability to judge distances that can lead to under- or overshoot in grasping movements), and dysdiadochokinesia (inability to perform rapid movements requiring antagonizing muscle groups to be switched on and off repeatedly). Evidence: TAS. Frequency: Frequent (HP:0040282). (ORPHA:363400)
- Spasticity (HP:0001257): A motor disorder characterized by a velocity-dependent increase in tonic stretch reflexes with increased muscle tone, exaggerated (hyperexcitable) tendon reflexes. Evidence: TAS. Frequency: Frequent (HP:0040282). (ORPHA:363400)
- Myoclonus (HP:0001336): Very brief, involuntary random muscular contractions occurring at rest, in response to sensory stimuli, or accompanying voluntary movements. Evidence: TAS. Frequency: Frequent (HP:0040282). (ORPHA:363400)
- Tremor (HP:0001337): An unintentional, oscillating to-and-fro muscle movement about a joint axis. Evidence: TAS. Frequency: Frequent (HP:0040282). (ORPHA:363400)
- Hyperreflexia (HP:0001347): Hyperreflexia is the presence of hyperactive stretch reflexes of the muscles. Evidence: TAS. Frequency: Frequent (HP:0040282). (ORPHA:363400)
- Brisk reflexes (HP:0001348): Tendon reflexes that are noticeably more active than usual (conventionally denoted 3+ on clinical examination). Brisk reflexes may or may not indicate a neurological lesion. They are distinguished from hyperreflexia by the fact that hyerreflexia is characterized by hyperactive repeating (clonic) reflexes, which are considered to be always abnormal. Evidence: TAS. Frequency: Frequent (HP:0040282). (ORPHA:363400)
- Hepatic steatosis (HP:0001397): Steatosis is a term used to denote lipid accumulation within hepatocytes. Evidence: TAS. Frequency: Frequent (HP:0040282). (ORPHA:363400)
- Hypertriglyceridemia (HP:0002155): An abnormal increase in the level of triglycerides in the blood. Evidence: TAS. Frequency: Frequent (HP:0040282). (ORPHA:363400)
- Incoordination (HP:0002311): A deficit in coordination of muscle movements. Coordination is defined as the orchestrated movement of multiple body parts as required to accomplish intended actions, like walking. Evidence: TAS. Frequency: Frequent (HP:0040282). (ORPHA:363400)
- Sleep disturbance (HP:0002360): An abnormal pattern in the quality, quantity, or characteristics of sleep. Evidence: TAS. Frequency: Frequent (HP:0040282). (ORPHA:363400)
- Abnormal pyramidal sign (HP:0007256): Functional neurological abnormalities related to dysfunction of the pyramidal tract. Evidence: TAS. Frequency: Frequent (HP:0040282). (ORPHA:363400)
- Hyperactivity (HP:0000752): Hyperactivity is a condition characterized by constant and unusually high levels of activity, even in situations where it is deemed inappropriate. Evidence: TAS. Frequency: Occasional (HP:0040283). (ORPHA:363400)
- Hypertension (HP:0000822): The presence of chronic increased pressure in the systemic arterial system. Evidence: TAS. Frequency: Occasional (HP:0040283). (ORPHA:363400)
- Acanthosis nigricans (HP:0000956): A dermatosis characterized by thickened, hyperpigmented plaques, typically on the intertriginous surfaces and neck. Evidence: TAS. Frequency: Occasional (HP:0040283). (ORPHA:363400)
- Cirrhosis (HP:0001394): A chronic disorder of the liver in which liver tissue becomes scarred and is partially replaced by regenerative nodules and fibrotic tissue resulting in loss of liver function. Evidence: TAS. Frequency: Occasional (HP:0040283). (ORPHA:363400)
- Cerebral atrophy (HP:0002059): Atrophy (wasting, decrease in size of cells or tissue) affecting the cerebrum. Evidence: TAS. Frequency: Occasional (HP:0040283). (ORPHA:363400)
- Gait ataxia (HP:0002066): A type of ataxia characterized by the impairment of the ability to coordinate the movements required for normal walking. Gait ataxia is characteirzed by a wide-based staggering gait with a tendency to fall. Evidence: TAS. Frequency: Occasional (HP:0040283). (ORPHA:363400)
- Generalized hirsutism (HP:0002230): Abnormally increased hair growth over much of the entire body. Evidence: TAS. Frequency: Occasional (HP:0040283). (ORPHA:363400)
- Hepatomegaly (HP:0002240): Abnormally increased size of the liver. Evidence: TAS. Frequency: Occasional (HP:0040283). (ORPHA:363400)
- Tetraparesis (HP:0002273): Weakness of all four limbs. Evidence: TAS. Frequency: Occasional (HP:0040283). (ORPHA:363400)
- Caudate atrophy (HP:0002340). Evidence: TAS. Frequency: Occasional (HP:0040283). (ORPHA:363400)
- Limb dystonia (HP:0002451): A type of dystonia (abnormally increased muscular tone causing fixed abnormal postures) that affects muscles of the limbs. Evidence: TAS. Frequency: Occasional (HP:0040283). (ORPHA:363400)
- Neuronal loss in central nervous system (HP:0002529). Evidence: TAS. Frequency: Occasional (HP:0040283). (ORPHA:363400)
- Respiratory failure (HP:0002878): A severe form of respiratory insufficiency characterized by inadequate gas exchange such that the levels of oxygen or carbon dioxide cannot be maintained within normal limits. Evidence: TAS. Frequency: Occasional (HP:0040283). (ORPHA:363400)
- Myopathy (HP:0003198): A disorder of muscle unrelated to impairment of innervation or neuromuscular junction. Evidence: TAS. Frequency: Occasional (HP:0040283). (ORPHA:363400)
- Status epilepticus (HP:0002133): Status epilepticus is a type of prolonged seizure resulting either from the failure of the mechanisms responsible for seizure termination or from the initiation of mechanisms which lead to abnormally prolonged seizures (after time point t1). It is a condition that can have long-term consequences (after time point t2), including neuronal death, neuronal injury, and alteration of neuronal networks, depending on the type and duration of seizures. Evidence: TAS. Frequency: Very rare (HP:0040284). (ORPHA:363400)
These phenotypes are associated with the disease Progressive encephalopathy-severe neurodegeneration-lipodystrophy syndrome (ORPHA:363400).